Phenotypes associated with the disease xeroderma pigmentosum group E (OMIM:278740):
- Melanoma (HP:0002861): The presence of a melanoma, a malignant cancer originating from pigment producing melanocytes. Melanoma can originate from the skin or the pigmented layers of the eye (the uvea). Evidence: TAS. (OMIM:278740)
- Cutaneous photosensitivity (HP:0000992): An increased sensitivity of the skin to light. Photosensitivity may result in a rash upon exposure to the sun (which is known as photodermatosis). Photosensitivity can be diagnosed by phototests in which light is shone on small areas of skin. Evidence: IEA. (OMIM:278740)
- Defective DNA repair after ultraviolet radiation damage (HP:0003079). Evidence: IEA. (OMIM:278740)
- Dermal atrophy (HP:0004334): Partial or complete wasting (atrophy) of the skin. Evidence: IEA. (OMIM:278740)
- Keratitis (HP:0000491): Inflammation of the cornea. Evidence: IEA. (OMIM:278740)
- Squamous cell carcinoma of the skin (HP:0006739): Squamous cell carcinoma of the skin is a malignant tumor of squamous epithelium. Evidence: TAS. (OMIM:278740)
- Basal cell carcinoma (HP:0002671): The presence of a basal cell carcinoma of the skin. Evidence: TAS. (OMIM:278740)
- Conjunctivitis (HP:0000509): Inflammation of the conjunctiva. Evidence: IEA. (OMIM:278740)
- Photophobia (HP:0000613): Excessive sensitivity to light with the sensation of discomfort or pain in the eyes due to exposure to bright light. Evidence: IEA. (OMIM:278740)
- Telangiectasia (HP:0001009): Telangiectasias refer to small dilated blood vessels located near the surface of the skin or mucous membranes, measuring between 0.5 and 1 millimeter in diameter. Telangiectasia are located especially on the tongue, lips, palate, fingers, face, conjunctiva, trunk, nail beds, and fingertips. Evidence: IEA. (OMIM:278740)
- Autosomal recessive inheritance (HP:0000007): A mode of inheritance that is observed for traits related to a gene encoded on one of the autosomes (i.e., the human chromosomes 1-22) in which a trait manifests in individuals with two pathogenic alleles, either homozygotes (two copies of the same mutant allele) or compound heterozygotes (whereby each copy of a gene has a distinct mutant allele). Evidence: IEA. (OMIM:278740)
- Ectropion (HP:0000656): An outward turning (eversion) or rotation of the eyelid margin. Evidence: IEA. (OMIM:278740)
- Poikiloderma (HP:0001029): Poikiloderma refers to a patch of skin with (1) reticulated hypopigmentation and hyperpigmentation, (2) wrinkling secondary to epidermal atrophy, and (3) telangiectasias. Evidence: IEA. (OMIM:278740)
- Entropion (HP:0000621): An abnormal inversion (turning inward) of the eyelid (usually the lower) towards the globe. Entropion is usually acquired as a result of involutional or cicatricial processes but may occasionally be congenital. Evidence: IEA. (OMIM:278740)